Phenotypes associated with the disease chromosome 3q29 microdeletion syndrome (OMIM:609425):
- Gait ataxia (HP:0002066): A type of ataxia characterized by the impairment of the ability to coordinate the movements required for normal walking. Gait ataxia is characteirzed by a wide-based staggering gait with a tendency to fall. Evidence: PCS. (PMID:15918153)
- Failure to thrive (HP:0001508): Failure to thrive (FTT) refers to a child whose physical growth is substantially below the norm. Evidence: TAS. (OMIM:609425)
- Aggressive behavior (HP:0000718): Behavior or an act aimed at harming a person, animal, or physical property (e.g., acts of physical violence; shouting, swearing, and using harsh language; slashing someone's tires). Evidence: TAS. (OMIM:609425)
- Autism (HP:0000717): Autism is a neurodevelopmental disorder characterized by impaired social interaction and communication, and by restricted and repetitive behavior. Autism begins in childhood. It is marked by the presence of markedly abnormal or impaired development in social interaction and communication and a markedly restricted repertoire of activity and interest. Manifestations of the disorder vary greatly depending on the developmental level and chronological age of the individual (DSM-IV). Evidence: PCS. (PMID:15918153)
- Anxiety (HP:0000739): Intense feelings of nervousness, tension, or panic often arise in response to interpersonal stresses. There is worry about the negative effects of past unpleasant experiences and future negative possibilities. Individuals may feel fearful, apprehensive, or threatened by uncertainty, and they may also have fears of falling apart or losing control. Evidence: TAS. (OMIM:609425)
- Motor stereotypy (HP:0000733): Use of the same abnormal action in response to certain triggers or at random. They may be used as a way to regulate one's internal state but must otherwise have no apparent functional purpose. Evidence: PCS. (PMID:15918153)
- Long fingers (HP:0100807): The middle finger is more than 2 SD above the mean for newborns 27 to 41 weeks EGA or above the 97th centile for children from birth to 16 years of age AND the five digits retain their normal length proportions relative to each other (i.e., it is not the case that the middle finger is the only lengthened digit), or, Fingers that appear disproportionately long compared to the palm of the hand. Evidence: PCS. (PMID:15918153)
- Thin upper lip vermilion (HP:0000219): Height of the vermilion of the upper lip in the midline more than 2 SD below the mean. Alternatively, an apparently reduced height of the vermilion of the upper lip in the frontal view (subjective). Evidence: TAS. (OMIM:609425)
- Sporadic (HP:0003745): Cases of the disease in question occur without a previous family history, i.e., as isolated cases without being transmitted from a parent and without other siblings being affected. Evidence: IEA. (OMIM:609425)
- Hyperactivity (HP:0000752): Hyperactivity is a condition characterized by constant and unusually high levels of activity, even in situations where it is deemed inappropriate. Evidence: TAS. (OMIM:609425)
- Posteriorly rotated ears (HP:0000358): A type of abnormal location of the ears in which the position of the ears is characterized by posterior rotation (the superior part of the ears is rotated towards the back of the head, and the inferior part of the ears towards the front). Evidence: TAS. (OMIM:609425)
- Intellectual disability (HP:0001249): The term intellectual disability or intellectual developmental disorder is used to describe significantly sub-average intellectual and adaptive functioning based on clinical assessment and as measured by individually administered, appropriately normed, standardized and validated tests of intellectual functioning and adaptive behavior, with onset during the developmental period from infancy through adolescence. Evidence: PCS. (PMID:15918153)
- Narrow face (HP:0000275): Bizygomatic (upper face) and bigonial (lower face) width are both more than 2 standard deviations below the mean (objective); or, an apparent reduction in the width of the upper and lower face (subjective). Evidence: PCS. (PMID:15918153)
- Microcephaly (HP:0000252): Head circumference below 2 standard deviations below the mean for age and gender. Evidence: PCS. (PMID:15918153)
- Long face (HP:0000276): Facial height (length) is more than 2 standard deviations above the mean (objective); or, an apparent increase in the height (length) of the face (subjective). Evidence: PCS. (PMID:15918153)
- Global developmental delay (HP:0001263): A delay in the achievement of motor or mental milestones in the domains of development of a child, including motor skills, speech and language, cognitive skills, and social and emotional skills. This term should only be used to describe children younger than five years of age. Evidence: PCS. Onset: Infantile onset (HP:0003593). (PMID:15918153)
- Tapered finger (HP:0001182): The gradual reduction in girth of the finger from proximal to distal. Evidence: PCS. (PMID:15918153)
- Psychosis (HP:0000709): A condition characterized by changes in personality and thought patterns, often accompanied by hallucinations and delusional beliefs, is known as psychosis. Evidence: TAS. (OMIM:609425)
- Small for gestational age (HP:0001518): Smaller than normal size according to sex and gestational age related norms, defined as a weight below the 10th percentile for the gestational age. Evidence: TAS. (OMIM:609425)
- Prominent nasal bridge (HP:0000426): Anterior positioning of the nasal root in comparison to the usual positioning for age. Evidence: PCS. (PMID:15918153)
- Pectus excavatum (HP:0000767): A defect of the chest wall characterized by a depression of the sternum, giving the chest ("pectus") a caved-in ("excavatum") appearance. Evidence: PCS. (PMID:15918153)
- Pectus carinatum (HP:0000768): A deformity of the chest caused by overgrowth of the ribs and characterized by protrusion of the sternum. Evidence: PCS. (PMID:15918153)
- Clinodactyly of the 5th finger (HP:0004209): Clinodactyly refers to a bending or curvature of the fifth finger in the radial direction (i.e., towards the 4th finger). Evidence: PCS. (PMID:15918153)
- Macrotia (HP:0000400): Median longitudinal ear length greater than two standard deviations above the mean and median ear width greater than two standard deviations above the mean (objective); or, apparent increase in length and width of the pinna (subjective). Evidence: TAS. (OMIM:609425)
- Short philtrum (HP:0000322): Distance between nasal base and midline upper lip vermilion border more than 2 SD below the mean. Alternatively, an apparently decreased distance between nasal base and midline upper lip vermilion border. Evidence: PCS. (PMID:15918153)
- Autosomal dominant inheritance (HP:0000006): A mode of inheritance that is observed for traits related to a gene encoded on one of the autosomes (i.e., the human chromosomes 1-22) in which a trait manifests in heterozygotes. In the context of medical genetics, an autosomal dominant disorder is caused when a single copy of the mutant allele is present. Males and females are affected equally, and can both transmit the disorder with a risk of 50% for each child of inheriting the mutant allele. Evidence: IEA. (OMIM:609425)
- Low-set ears (HP:0000369): Upper insertion of the ear to the scalp below an imaginary horizontal line drawn between the inner canthi of the eye and extending posteriorly to the ear. Evidence: TAS. (OMIM:609425)